Phenotypes associated with the disease Lymphedema with yellow nails (ORPHA:662):
- Nephropathy (HP:0000112): A nonspecific term referring to disease or damage of the kidneys. Evidence: TAS. Frequency: Occasional (HP:0040283). (ORPHA:662)
- Sinusitis (HP:0000246): Inflammation of the paranasal sinuses owing to a viral, bacterial, or fungal infection, allergy, or an autoimmune reaction. Evidence: TAS. Frequency: Frequent (HP:0040282). (ORPHA:662)
- Lymphedema (HP:0001004): Localized fluid retention and tissue swelling caused by a compromised lymphatic system. Evidence: TAS. Frequency: Very frequent (HP:0040281). (ORPHA:662)
- Abnormal fingernail morphology (HP:0001231): An abnormality of the fingernails. Evidence: TAS. Frequency: Very frequent (HP:0040281). (ORPHA:662)
- Onycholysis (HP:0001806): Detachment of the nail from the nail bed. Evidence: TAS. Frequency: Occasional (HP:0040283). (ORPHA:662)
- Pulmonary arterial hypertension (HP:0002092): Pulmonary hypertension is defined mean pulmonary artery pressure of 25mmHg or more and pulmonary capillary wedge pressure of 15mmHg or less when measured by right heart catheterisation at rest and in a supine position. Evidence: TAS. Frequency: Occasional (HP:0040283). (ORPHA:662)
- Dyspnea (HP:0002094): Difficult or labored breathing. Dyspnea is a subjective feeling only the patient can rate, e.g., on a Borg scale. Evidence: TAS. Frequency: Frequent (HP:0040282). (ORPHA:662)
- Pleuritis (HP:0002102): Inflammation of the pleura. Evidence: TAS. Frequency: Frequent (HP:0040282). (ORPHA:662)
- Bronchiectasis (HP:0002110): Persistent abnormal dilatation of the bronchi owing to localized and irreversible destruction and widening of the large airways. Evidence: TAS. Frequency: Very frequent (HP:0040281). (ORPHA:662)
- Recurrent respiratory infections (HP:0002205): An increased susceptibility to respiratory infections as manifested by a history of recurrent respiratory infections. Evidence: TAS. Frequency: Frequent (HP:0040282). (ORPHA:662)
- Neoplasm (HP:0002664): An organ or organ-system abnormality that consists of uncontrolled autonomous cell-proliferation which can occur in any part of the body as a benign or malignant neoplasm (tumor). Evidence: TAS. Frequency: Occasional (HP:0040283). (ORPHA:662)
- Immunodeficiency (HP:0002721): Failure of the immune system to protect the body adequately from infection, due to the absence or insufficiency of some component process or substance. Evidence: TAS. Frequency: Occasional (HP:0040283). (ORPHA:662)
- Hypoplasia of lymphatic vessels (HP:0003759): Congenital underdevelopment of lymph vessels. Evidence: TAS. Frequency: Very frequent (HP:0040281). (ORPHA:662)
- Abnormal toenail morphology (HP:0008388): An anomaly of the toenail. Evidence: TAS. Frequency: Very frequent (HP:0040281). (ORPHA:662)
- Renal neoplasm (HP:0009726): The presence of a neoplasm of the kidney. Evidence: TAS. Frequency: Occasional (HP:0040283). (ORPHA:662)
- Generalized abnormality of skin (HP:0011354): An abnormality of the skin that is not localized to any one particular region. Evidence: TAS. Frequency: Occasional (HP:0040283). (ORPHA:662)
- Yellow nails (HP:0011367): Yellowish discoloration of the nails. Evidence: TAS. Frequency: Very frequent (HP:0040281). (ORPHA:662)
- Rhinitis (HP:0012384): Inflammation of the nasal mucosa with nasal congestion. Evidence: TAS. Frequency: Frequent (HP:0040282). (ORPHA:662)
- Cough (HP:0012735): A sudden, audible expulsion of air from the lungs through a partially closed glottis, preceded by inhalation. Evidence: TAS. Frequency: Frequent (HP:0040282). (ORPHA:662)
- Sarcoma (HP:0100242): A connective tissue neoplasm formed by proliferation of mesodermal cells. Bone and soft tissue sarcomas are the main types of sarcoma. Sarcoma is usually highly malignant. Evidence: TAS. Frequency: Occasional (HP:0040283). (ORPHA:662)
- Neoplasm of the lung (HP:0100526): Tumor of the lung. Evidence: TAS. Frequency: Occasional (HP:0040283). (ORPHA:662)
- Biliary tract neoplasm (HP:0100574): A tumor (abnormal growth of tissue) of the biliary system. Evidence: TAS. Frequency: Occasional (HP:0040283). (ORPHA:662)
- Toenail dysplasia (HP:0100797): An abnormality of the development of the toenails. Evidence: TAS. Frequency: Very frequent (HP:0040281). (ORPHA:662)
- Fingernail dysplasia (HP:0100798): An abnormality of the development of the fingernails. Evidence: TAS. Frequency: Very frequent (HP:0040281). (ORPHA:662)